- Sensorineural hearing impairment (HP:0000407): A type of hearing impairment in one or both ears related to an abnormal functionality of the cochlear nerve. Evidence: PCS. (PMID:30610177)
- Autosomal recessive inheritance (HP:0000007): A mode of inheritance that is observed for traits related to a gene encoded on one of the autosomes (i.e., the human chromosomes 1-22) in which a trait manifests in individuals with two pathogenic alleles, either homozygotes (two copies of the same mutant allele) or compound heterozygotes (whereby each copy of a gene has a distinct mutant allele). Evidence: IEA. (OMIM:618456)
These phenotypes are associated with the disease hearing loss, autosomal recessive 114 (OMIM:618456).